- Edema (HP:0000969): An abnormal accumulation of fluid beneath the skin, or in one or more cavities of the body. Evidence: TAS. Frequency: Very frequent (HP:0040281). (ORPHA:449285)
- Erythema (HP:0010783): Redness of the skin, caused by hyperemia of the capillaries in the lower layers of the skin. Evidence: TAS. Frequency: Frequent (HP:0040282). (ORPHA:449285)
- Localized skin lesion (HP:0011355): A lesion of the skin that is located in a specific region rather than being generalized. Evidence: TAS. Frequency: Frequent (HP:0040282). (ORPHA:449285)
- Pain (HP:0012531): An unpleasant sensory and emotional experience associated with actual or potential tissue damage, or described in terms of such damage. Evidence: TAS. Frequency: Frequent (HP:0040282). (ORPHA:449285)
- Ecchymosis (HP:0031364): A purpuric lesion that is larger than 1 cm in diameter. Evidence: TAS. Frequency: Frequent (HP:0040282). (ORPHA:449285)
- Abnormality of the nervous system (HP:0000707): An abnormality of the nervous system. Evidence: TAS. Frequency: Occasional (HP:0040283). (ORPHA:449285)
- Stroke (HP:0001297): Sudden impairment of blood flow to a part of the brain due to occlusion or rupture of an artery to the brain. Evidence: TAS. Frequency: Occasional (HP:0040283). (ORPHA:449285)
- Tachycardia (HP:0001649): A rapid heartrate that exceeds the range of the normal resting heartrate for age. Evidence: TAS. Frequency: Occasional (HP:0040283). (ORPHA:449285)
- Thrombocytopenia (HP:0001873): A reduction in the number of circulating thrombocytes. Evidence: TAS. Frequency: Occasional (HP:0040283). (ORPHA:449285)
- Abnormal bleeding (HP:0001892): An abnormal susceptibility to bleeding, often referred to as a bleeding diathesis. A bleeding diathesis may be related to vascular, platelet and coagulation defects. Evidence: TAS. Frequency: Occasional (HP:0040283). (ORPHA:449285)
- Abnormality of coagulation (HP:0001928): An abnormality of the process of blood coagulation. That is, altered ability or inability of the blood to clot. Evidence: TAS. Frequency: Occasional (HP:0040283). (ORPHA:449285)
- Vomiting (HP:0002013): Forceful ejection of the contents of the stomach through the mouth by means of a series of involuntary spasmic contractions. Evidence: TAS. Frequency: Occasional (HP:0040283). (ORPHA:449285)
- Intracranial hemorrhage (HP:0002170): Hemorrhage occurring within the skull. Evidence: TAS. Frequency: Occasional (HP:0040283). (ORPHA:449285)
- Cerebral ischemia (HP:0002637): Restriction of arterial blood supply to the brain associated with insufficient oxygenation to support the metabolic requirements of the tissue. Evidence: TAS. Frequency: Occasional (HP:0040283). (ORPHA:449285)
- Rhabdomyolysis (HP:0003201): Breakdown of muscle fibers that leads to the release of muscle fiber contents (myoglobin) into the bloodstream. Evidence: TAS. Frequency: Occasional (HP:0040283). (ORPHA:449285)
- Paralysis (HP:0003470): Paralysis of voluntary muscles means loss of contraction due to interruption of one or more motor pathways from the brain to the muscle fibers. Although the word paralysis is often used interchangeably to mean either complete or partial loss of muscle strength, it is preferable to use paralysis or plegia for complete or severe loss of muscle strength, and paresis for partial or slight loss. Motor paralysis results from deficits of the upper motor neurons (corticospinal, corticobulbar, or subcorticospinal). Motor paralysis is often accompanied by an impairment in the facility of movement. Evidence: TAS. Frequency: Occasional (HP:0040283). (ORPHA:449285)
- Muscle fiber necrosis (HP:0003713): Abnormal cell death involving muscle fibers usually associated with break in, or absence of, muscle surface fiber membrane and resulting in irreversible damage to muscle fibers. Evidence: TAS. Frequency: Occasional (HP:0040283). (ORPHA:449285)
- Pseudobulbar paralysis (HP:0007024): Bilateral impairment of the function of the cranial nerves 9-12, which control musculature involved in eating, swallowing, and speech. Pseudobulbar paralysis is characterized clinically by dysarthria, dysphonia, and dysphagia with bifacial paralysis, and may be accompanied by Pseudobulbar behavioral symptoms such as enforced crying and laughing. Evidence: TAS. Frequency: Occasional (HP:0040283). (ORPHA:449285)
- Speech articulation difficulties (HP:0009088): Impairment in the physical production of speech sounds. Evidence: TAS. Frequency: Occasional (HP:0040283). (ORPHA:449285)
- Hypofibrinogenemia (HP:0011900): Decreased concentration of fibrinogen in the blood. Evidence: TAS. Frequency: Occasional (HP:0040283). (ORPHA:449285)
- Gingival bleeding (HP:0000225): Hemorrhage affecting the gingiva. Evidence: TAS. Frequency: Very rare (HP:0040284). (ORPHA:449285)
- Epistaxis (HP:0000421): Epistaxis, or nosebleed, refers to a hemorrhage localized in the nose. Evidence: TAS. Frequency: Very rare (HP:0040284). (ORPHA:449285)
- Myocardial infarction (HP:0001658): Necrosis of the myocardium caused by an obstruction of the blood supply to the heart and often associated with chest pain, shortness of breath, palpitations, and anxiety as well as characteristic EKG findings and elevation of serum markers including creatine kinase-MB fraction and troponin. Evidence: TAS. Frequency: Very rare (HP:0040284). (ORPHA:449285)
- Acute kidney injury (HP:0001919): Sudden loss of renal function, as manifested by decreased urine production, and a rise in serum creatinine or blood urea nitrogen concentration (azotemia). Evidence: TAS. Frequency: Very rare (HP:0040284). (ORPHA:449285)
- Diarrhea (HP:0002014): Abnormally increased frequency (usually defined as three or more) loose or watery bowel movements a day. Evidence: TAS. Frequency: Very rare (HP:0040284). (ORPHA:449285)
- Neuromuscular dysphagia (HP:0002068). Evidence: TAS. Frequency: Very rare (HP:0040284). (ORPHA:449285)
- Respiratory paralysis (HP:0002203): Inability to move the muscles of respiration. Evidence: TAS. Frequency: Very rare (HP:0040284). (ORPHA:449285)
- Hypotension (HP:0002615): Low Blood Pressure, vascular hypotension. Evidence: TAS. Frequency: Very rare (HP:0040284). (ORPHA:449285)
- Respiratory failure (HP:0002878): A severe form of respiratory insufficiency characterized by inadequate gas exchange such that the levels of oxygen or carbon dioxide cannot be maintained within normal limits. Evidence: TAS. Frequency: Very rare (HP:0040284). (ORPHA:449285)
- Hyponatremia (HP:0002902): The concentration of sodium in the blood circulation is below the lower limit of normal. Evidence: TAS. Frequency: Very rare (HP:0040284). (ORPHA:449285)
- Disseminated intravascular coagulation (HP:0005521): Disseminated intravascular coagulation is characterized by the widespread activation of coagulation, which results in the intravascular formation of fibrin and ultimately thrombotic occlusion of small and midsize vessels. Evidence: TAS. Frequency: Very rare (HP:0040284). (ORPHA:449285)
- Cardiogenic shock (HP:0030149): Severely decreased cardiac output with evidence of inadequate end-organ perfusion (i.e., tissue hypoxia) in the presence of adequate intravascular volume. Evidence: TAS. Frequency: Very rare (HP:0040284). (ORPHA:449285)
- Hypopituitarism (HP:0040075). Evidence: TAS. Frequency: Very rare (HP:0040284). (ORPHA:449285)
- Angioedema (HP:0100665): Rapid swelling (edema) of the dermis, subcutaneous tissue, mucosa and submucosal tissues of the skin of the face, normally around the mouth, and the mucosa of the mouth and/or throat, as well as the tongue during a period of minutes to several hours. The swelling can also occur elsewhere, typically in the hands. Angioedema is similar to urticaria, but the swelling is subcutaneous rather than on the epidermis. Evidence: TAS. Frequency: Very rare (HP:0040284). (ORPHA:449285)
These phenotypes are associated with the disease Snakebite envenomation (ORPHA:449285).